- Meconium ileus (HP:0004401): Obstruction of the intestine due to abnormally thick meconium. Evidence: IEA. (OMIM:603855)
This phenotype is associated with the disease Cystic fibrosis, modifier of, 1 (OMIM:603855).